- Female infertility (HP:0008222). Evidence: PCS. Frequency: 2/2. (PMID:39209701)
- Young adult onset (HP:0011462): Onset of disease at the age of between 16 and 40 years. Evidence: PCS. Frequency: 2/2. (PMID:39209701)
- Autosomal recessive inheritance (HP:0000007): A mode of inheritance that is observed for traits related to a gene encoded on one of the autosomes (i.e., the human chromosomes 1-22) in which a trait manifests in individuals with two pathogenic alleles, either homozygotes (two copies of the same mutant allele) or compound heterozygotes (whereby each copy of a gene has a distinct mutant allele). Evidence: PCS. (PMID:39209701)
- Embryo developmental arrest (HP:0020003): A failure of an embryo to progress through the early stages of preimplantation development (typically from fertilization, i.e., 1-cell zygote, to blastocyst on day 5-6), and is used clinically when embryos fail to reach transferable stages in assisted reproductive technologies (ARTs) such in vitro fertilization (IVF). Arrested embryo development is characterized by downregulation of metabolic activity and cessation of cell division. In order for an embryo to be characterized as non-viable, i.e., arrested, it should present with a lack of cleaving activity and fail to show a sign of mitotic cellular division for at least 24 hours. One can observe failure of a zygote to cleave, cleavage stage arrest either on day 2 or day 3 when the embryo is expected to be between the 2 and 8-cell stage, failure to compact to morula, or failure to form a blastocyst. Evidence: PCS. Frequency: 2/2. (PMID:39209701)
- Repeated implantation failure (HP:0033712): Repeated implantation failure refers to a situation in which embryos of good quality fail to implant following several in vitro fertilization (IVF) treatment cycles. Evidence: PCS. Frequency: 2/2. (PMID:39209701)
These phenotypes are associated with the disease oocyte/zygote/embryo maturation arrest 24 (OMIM:621232).